Phenotypes associated with the disease MFF-related encephalopathy due to mitochondrial and peroxisomal fission defect (ORPHA:485421):
- Nasogastric tube feeding (HP:0040288): The condition of inability to eat normally treated by placement of a thin tube through the nose into the stomach that is then used to carry food. Evidence: TAS. Frequency: Frequent (HP:0040282). (ORPHA:485421)
- Growth delay (HP:0001510): A deficiency or slowing down of growth pre- and postnatally. Evidence: TAS. Frequency: Occasional (HP:0040283). (ORPHA:485421)
- Epileptic spasm (HP:0011097): A sudden flexion, extension, or mixed extension-flexion of predominantly proximal and truncal muscles that is usually more sustained than a myoclonic movement but not as sustained as a tonic seizure. Limited forms may occur: Grimacing, head nodding, or subtle eye movements. Epileptic spasms frequently occur in clusters. Infantile spasms are the best known form, but spasms can occur at all ages. Evidence: TAS. Frequency: Occasional (HP:0040283). (ORPHA:485421)
- Visual impairment (HP:0000505): Visual impairment (or vision impairment) is vision loss (of a person) to such a degree as to qualify as an additional support need through a significant limitation of visual capability resulting from either disease, trauma, or congenital or degenerative conditions that cannot be corrected by conventional means, such as refractive correction, medication, or surgery. Evidence: TAS. Frequency: Frequent (HP:0040282). (ORPHA:485421)
- Optic disc pallor (HP:0000543): A pale yellow discoloration of the optic disc (the area of the optic nerve head in the retina). The optic disc normally has a pinkish hue with a central yellowish depression. Evidence: TAS. Frequency: Frequent (HP:0040282). (ORPHA:485421)
- External ophthalmoplegia (HP:0000544): Paralysis of the external ocular muscles. Evidence: TAS. Frequency: Frequent (HP:0040282). (ORPHA:485421)
- Optic atrophy (HP:0000648): Atrophy of the optic nerve. Optic atrophy results from the death of the retinal ganglion cell axons that comprise the optic nerve and manifesting as a pale optic nerve on fundoscopy. Evidence: TAS. Frequency: Frequent (HP:0040282). (ORPHA:485421)
- Abnormality of visual evoked potentials (HP:0000649): An anomaly of visually evoked potentials (VEP), which are electrical potentials, initiated by brief visual stimuli, which are recorded from the scalp overlying the visual cortex. Evidence: TAS. Frequency: Frequent (HP:0040282). (ORPHA:485421)
- Abnormal nonverbal communicative behavior (HP:0000758): Abnormalities in eye contact, communicative facial expressions, gesture use, or the use of others' bodies to communicate convey shared meanings within a culture that replace or supplement verbal communication. Evidence: TAS. Frequency: Frequent (HP:0040282). (ORPHA:485421)
- Decreased nerve conduction velocity (HP:0000762): A reduction in the speed at which electrical signals propagate along the axon of a neuron. Evidence: TAS. Frequency: Frequent (HP:0040282). (ORPHA:485421)
- Seizure (HP:0001250): A seizure is an intermittent abnormality of nervous system physiology characterized by a transient occurrence of signs and/or symptoms due to abnormal excessive or synchronous neuronal activity in the brain. Evidence: TAS. Frequency: Frequent (HP:0040282). (ORPHA:485421)
- Spasticity (HP:0001257): A motor disorder characterized by a velocity-dependent increase in tonic stretch reflexes with increased muscle tone, exaggerated (hyperexcitable) tendon reflexes. Evidence: TAS. Frequency: Frequent (HP:0040282). (ORPHA:485421)
- Motor delay (HP:0001270): A type of Developmental delay characterized by a delay in acquiring motor skills. Evidence: TAS. Frequency: Frequent (HP:0040282). (ORPHA:485421)
- Cerebellar atrophy (HP:0001272): Cerebellar atrophy is defined as a cerebellum with initially normal structures, in a posterior fossa with normal size, which displays enlarged fissures (interfolial spaces) in comparison to the foliae secondary to loss of tissue. Cerebellar atrophy implies irreversible loss of tissue and result from an ongoing progressive disease until a final stage is reached or a single injury, e.g. an intoxication or infectious event. Evidence: TAS. Frequency: Frequent (HP:0040282). (ORPHA:485421)
- Muscle weakness (HP:0001324): Reduced strength of muscles. Evidence: TAS. Frequency: Frequent (HP:0040282). (ORPHA:485421)
- Hyperreflexia (HP:0001347): Hyperreflexia is the presence of hyperactive stretch reflexes of the muscles. Evidence: TAS. Frequency: Frequent (HP:0040282). (ORPHA:485421)
- Dysphagia (HP:0002015): Difficulty in swallowing. Evidence: TAS. Frequency: Frequent (HP:0040282). (ORPHA:485421)
- EEG abnormality (HP:0002353): Abnormality observed by electroencephalogram (EEG), which is used to record of the brain's spontaneous electrical activity from multiple electrodes placed on the scalp. Evidence: TAS. Frequency: Frequent (HP:0040282). (ORPHA:485421)
- Developmental regression (HP:0002376): Loss of developmental skills, as manifested by loss of developmental milestones. Evidence: TAS. Frequency: Frequent (HP:0040282). (ORPHA:485421)
- Hypsarrhythmia (HP:0002521): Hypsarrhythmia is abnormal interictal high amplitude waves and a background of irregular spikes. There is continuous (during wakefulness), high-amplitude (>200 Hz), generalized polymorphic slowing with no organized background and multifocal spikes demonstrated by electroencephalography (EEG). Evidence: TAS. Frequency: Frequent (HP:0040282). (ORPHA:485421)
- Functional motor deficit (HP:0004302). Evidence: TAS. Frequency: Frequent (HP:0040282). (ORPHA:485421)
- Secondary microcephaly (HP:0005484): Head circumference which falls below 2 standard deviations below the mean for age and gender because of insufficient head growth after birth. Evidence: TAS. Frequency: Frequent (HP:0040282). (ORPHA:485421)
- Axial hypotonia (HP:0008936): Muscular hypotonia (abnormally low muscle tone) affecting the musculature of the trunk. Evidence: TAS. Frequency: Frequent (HP:0040282). (ORPHA:485421)
- Feeding difficulties (HP:0011968): Impaired ability to eat related to problems gathering food and getting ready to suck, chew, or swallow it. Evidence: TAS. Frequency: Frequent (HP:0040282). (ORPHA:485421)
- Abnormal mitochondrial shape (HP:0012087): An anomaly in the surface contour of mitochondria. Evidence: TAS. Frequency: Frequent (HP:0040282). (ORPHA:485421)
- Abnormal thalamic MRI signal intensity (HP:0012696): A deviation from normal signal on magnetic resonance imaging (MRI) of the thalamus. Evidence: TAS. Frequency: Frequent (HP:0040282). (ORPHA:485421)
- Profound global developmental delay (HP:0012736): A profound delay in the achievement of motor or mental milestones in the domains of development of a child. Evidence: TAS. Frequency: Frequent (HP:0040282). (ORPHA:485421)
- Abnormal basal ganglia MRI signal intensity (HP:0012751): A deviation from normal signal on magnetic resonance imaging (MRI) of the basal ganglia. Evidence: TAS. Frequency: Frequent (HP:0040282). (ORPHA:485421)
- Auditory sensitivity (HP:0025112): Decreased tolerance to sound. Evidence: TAS. Frequency: Frequent (HP:0040282). (ORPHA:485421)